- Autosomal dominant inheritance (HP:0000006): A mode of inheritance that is observed for traits related to a gene encoded on one of the autosomes (i.e., the human chromosomes 1-22) in which a trait manifests in heterozygotes. In the context of medical genetics, an autosomal dominant disorder is caused when a single copy of the mutant allele is present. Males and females are affected equally, and can both transmit the disorder with a risk of 50% for each child of inheriting the mutant allele. Evidence: TAS. (OMIM:167900)
- Hyperkeratosis (HP:0000962): Hyperkeratosis is a histopathological term defining a thickened stratum corneum and may be present in many different skin conditions, with many possible overlaps. Hyperkeratosis refers to the increased thickness of the stratum corneum, the outer layer of the skin. Hyperkeratosis is subclassified as orthokeratotic or parakeratotic. Orthokeratotic hyperkeratosis refers to the thickening of the keratin layer with preserved keratinocyte maturation, while parakeratotic hyperkeratosis shows retained nuclei as a sign of delayed maturation of keratinocytes. Evidence: TAS. (OMIM:167900)
These phenotypes are associated with the disease papillomatosis, confluent and reticulated (OMIM:167900).